- Hypertonia (HP:0001276): A condition in which there is increased muscle tone so that arms or legs, for example, are stiff and difficult to move. Evidence: IEA. (OMIM:176500)
- Progressive neurologic deterioration (HP:0002344). Evidence: IEA. (OMIM:176500)
- Cerebral amyloid angiopathy (HP:0011970): Amyloid deposition in the walls of leptomeningeal and cortical arteries, arterioles, and less often capillaries and veins of the central nervous system. Evidence: TAS. (OMIM:176500)
- Dementia (HP:0000726): A loss of global cognitive ability of sufficient amount to interfere with normal social or occupational function. Dementia represents a loss of previously present cognitive abilities, generally in adults, and can affect memory, thinking, language, judgment, and behavior. Evidence: TAS. (OMIM:176500)
- Rigidity (HP:0002063): Continuous involuntary sustained muscle contraction. When an affected muscle is passively stretched, the degree of resistance remains constant regardless of the rate at which the muscle is stretched. This feature helps to distinguish rigidity from muscle spasticity. Evidence: TAS. (OMIM:176500)
- Spasticity (HP:0001257): A motor disorder characterized by a velocity-dependent increase in tonic stretch reflexes with increased muscle tone, exaggerated (hyperexcitable) tendon reflexes. Evidence: TAS. (OMIM:176500)
- Autosomal dominant inheritance (HP:0000006): A mode of inheritance that is observed for traits related to a gene encoded on one of the autosomes (i.e., the human chromosomes 1-22) in which a trait manifests in heterozygotes. In the context of medical genetics, an autosomal dominant disorder is caused when a single copy of the mutant allele is present. Males and females are affected equally, and can both transmit the disorder with a risk of 50% for each child of inheriting the mutant allele. Evidence: IEA. (OMIM:176500)
- Tremor (HP:0001337): An unintentional, oscillating to-and-fro muscle movement about a joint axis. Evidence: IEA. (OMIM:176500)
These phenotypes are associated with the disease ABri amyloidosis (OMIM:176500).